Phenotypes associated with the disease Ataxia-photosensitivity-short stature syndrome (ORPHA:1184):
- High palate (HP:0000218): Height of the palate more than 2 SD above the mean (objective) or palatal height at the level of the first permanent molar more than twice the height of the teeth (subjective). Evidence: TAS. Frequency: Very frequent (HP:0040281). (ORPHA:1184)
- Dry skin (HP:0000958): Skin characterized by the lack of natural or normal moisture. Evidence: TAS. Frequency: Very frequent (HP:0040281). (ORPHA:1184)
- Cutaneous photosensitivity (HP:0000992): An increased sensitivity of the skin to light. Photosensitivity may result in a rash upon exposure to the sun (which is known as photodermatosis). Photosensitivity can be diagnosed by phototests in which light is shone on small areas of skin. Evidence: TAS. Frequency: Very frequent (HP:0040281). (ORPHA:1184)
- Urticaria (HP:0001025): Raised, well-circumscribed areas of erythema and edema involving the dermis and epidermis. Urticaria is intensely pruritic, and blanches completely with pressure. Evidence: TAS. Frequency: Very frequent (HP:0040281). (ORPHA:1184)
- Ataxia (HP:0001251): Ataxia refers to impaired coordination of voluntary muscle movement. Cerebellar ataxia refers to ataxia due to dysfunction of the cerebellum. This causes a variety of elementary neurological deficits including asynergy (lack of coordination between muscles, limbs and joints), dysmetria (lack of ability to judge distances that can lead to under- or overshoot in grasping movements), and dysdiadochokinesia (inability to perform rapid movements requiring antagonizing muscle groups to be switched on and off repeatedly). Evidence: TAS. Frequency: Very frequent (HP:0040281). (ORPHA:1184)
- Diminished deep tendon reflex (HP:0001315): A reduction (hyporeflexia) or complete absence (areflexia) of the involuntary muscle contraction normally elicited by a reflex stimulus, such as tapping a deep tendon. Evidence: TAS. Frequency: Very frequent (HP:0040281). (ORPHA:1184)
- Clinodactyly of the 5th finger (HP:0004209): Clinodactyly refers to a bending or curvature of the fifth finger in the radial direction (i.e., towards the 4th finger). Evidence: TAS. Frequency: Very frequent (HP:0040281). (ORPHA:1184)
- Short stature (HP:0004322): A height below that which is expected according to age and gender norms. Although there is no universally accepted definition of short stature, many refer to "short stature" as height more than 2 standard deviations below the mean for age and gender (or below the 3rd percentile for age and gender dependent norms). Evidence: TAS. Frequency: Very frequent (HP:0040281). (ORPHA:1184)
- Bilateral single transverse palmar creases (HP:0007598): The distal and proximal transverse palmar creases are merged into a single transverse palmar crease on both hands. Evidence: TAS. Frequency: Very frequent (HP:0040281). (ORPHA:1184)
- Abnormality of movement (HP:0100022): An abnormality of movement with a neurological basis characterized by changes in coordination and speed of voluntary movements. Evidence: TAS. Frequency: Very frequent (HP:0040281). (ORPHA:1184)
- Cognitive impairment (HP:0100543): Abnormal cognition is characterized by deficits in thinking, reasoning, or remembering. Evidence: TAS. Frequency: Very frequent (HP:0040281). (ORPHA:1184)
- Abnormality of the dentition (HP:0000164): Any abnormality of the teeth. Evidence: TAS. Frequency: Frequent (HP:0040282). (ORPHA:1184)
- Strabismus (HP:0000486): A misalignment of the eyes so that the visual axes deviate from bifoveal fixation. The classification of strabismus may be based on a number of features including the relative position of the eyes, whether the deviation is latent or manifest, intermittent or constant, concomitant or otherwise and according to the age of onset and the relevance of any associated refractive error. Evidence: TAS. Frequency: Frequent (HP:0040282). (ORPHA:1184)
- Gait disturbance (HP:0001288): The term gait disturbance can refer to any disruption of the ability to walk. Evidence: TAS. Frequency: Frequent (HP:0040282). (ORPHA:1184)
- Cubitus valgus (HP:0002967): Abnormal positioning in which the elbows are turned out. Evidence: TAS. Frequency: Frequent (HP:0040282). (ORPHA:1184)
- Abnormal cardiovascular system morphology (HP:0030680): Any structural anomaly of the heart and blood vessels. Evidence: TAS. Frequency: Frequent (HP:0040282). (ORPHA:1184)